- Young adult onset (HP:0011462): Onset of disease at the age of between 16 and 40 years. Evidence: TAS. (OMIM:600510)
- Open angle glaucoma (HP:0012108): A type of glaucoma defined by an open, normal appearing anterior chamber angle and raised intraocular pressure,. Evidence: TAS. (OMIM:600510)
- Optic atrophy (HP:0000648): Atrophy of the optic nerve. Optic atrophy results from the death of the retinal ganglion cell axons that comprise the optic nerve and manifesting as a pale optic nerve on fundoscopy. Evidence: TAS. (OMIM:600510)
- Myopia (HP:0000545): An abnormality of refraction characterized by the ability to see objects nearby clearly, while objects in the distance appear blurry. Evidence: TAS. (OMIM:600510)
- Autosomal dominant inheritance (HP:0000006): A mode of inheritance that is observed for traits related to a gene encoded on one of the autosomes (i.e., the human chromosomes 1-22) in which a trait manifests in heterozygotes. In the context of medical genetics, an autosomal dominant disorder is caused when a single copy of the mutant allele is present. Males and females are affected equally, and can both transmit the disorder with a risk of 50% for each child of inheriting the mutant allele. Evidence: TAS. (OMIM:600510)
These phenotypes are associated with the disease pigment dispersion syndrome (OMIM:600510).